Phenotypes associated with the disease benign paroxysmal positional vertigo (OMIM:193007):
- Hearing impairment (HP:0000365): A decreased magnitude of the sensory perception of sound. Evidence: PCS. Frequency: 0/3. (PMID:8290084)
- Vertigo (HP:0002321): An abnormal sensation of spinning while the body is actually stationary. Evidence: PCS. Frequency: 3/3. (PMID:8290084)
- Oscillopsia (HP:0034773): A visual disturbance in which objects in the visual field appear to oscillate (jump, jiggle, vibrate). Evidence: PCS. Frequency: 3/3. (PMID:8290084)
- Gait imbalance (HP:0002141). Evidence: PCS. Frequency: 3/3. (PMID:8290084)
- Autosomal dominant inheritance (HP:0000006): A mode of inheritance that is observed for traits related to a gene encoded on one of the autosomes (i.e., the human chromosomes 1-22) in which a trait manifests in heterozygotes. In the context of medical genetics, an autosomal dominant disorder is caused when a single copy of the mutant allele is present. Males and females are affected equally, and can both transmit the disorder with a risk of 50% for each child of inheriting the mutant allele. Evidence: PCS. (PMID:8290084)
- Slowly progressive (HP:0003677): Applies to a disease manifestation that only slowly increases in scope or severity over the course of time. Evidence: PCS. (PMID:8290084)